Phenotypes associated with the disease alopecia, androgenetic, 1 (OMIM:109200):
- Alopecia (HP:0001596): A noncongenital process of hair loss, which may progress to partial or complete baldness. Evidence: TAS. (OMIM:109200)
- Sex-limited expression (HP:0001470): Sex limitation is used to refer to a monogenic trait linked to an autosomal locus in which the phenotypic effects of allelic differences are expressed only in one sex. Evidence: IEA. (OMIM:109200)